Phenotypes associated with the disease intellectual disability, Wolff type (OMIM:277990):
- Intellectual disability (HP:0001249): The term intellectual disability or intellectual developmental disorder is used to describe significantly sub-average intellectual and adaptive functioning based on clinical assessment and as measured by individually administered, appropriately normed, standardized and validated tests of intellectual functioning and adaptive behavior, with onset during the developmental period from infancy through adolescence. Evidence: IEA. (OMIM:277990)